Phenotypes associated with the disease epilepsy, juvenile myoclonic, susceptibility to, 9 (OMIM:614280):
- Febrile seizure (within the age range of 3 months to 6 years) (HP:0002373): A febrile seizure is any type of seizure (most often a generalized tonic-clonic seizure) occurring with fever (at least 38 degrees Celsius) but in the absence of central nervous system infection, severe metabolic disturbance or other alternative precipitant in children between the ages of 3 months and 6 years. Evidence: TAS. Frequency: Occasional (HP:0040283). (OMIM:614280)
- Generalized non-motor (absence) seizure (HP:0002121): A generalized non-motor (absence) seizure is a type of a type of dialeptic seizure that is of electrographically generalized onset. It is a generalized seizure characterized by an interruption of activities, a blank stare, and usually the person will be unresponsive when spoken to. Any ictal motor phenomena are minor in comparison to these non-motor features. Evidence: TAS. Frequency: Occasional (HP:0040283). (OMIM:614280)
- Autosomal dominant inheritance (HP:0000006): A mode of inheritance that is observed for traits related to a gene encoded on one of the autosomes (i.e., the human chromosomes 1-22) in which a trait manifests in heterozygotes. In the context of medical genetics, an autosomal dominant disorder is caused when a single copy of the mutant allele is present. Males and females are affected equally, and can both transmit the disorder with a risk of 50% for each child of inheriting the mutant allele. Evidence: TAS. (OMIM:614280)